Phenotypes associated with the disease amelocerebrohypohidrotic syndrome (OMIM:226750):
- Bilateral tonic-clonic seizure (HP:0002069): A bilateral tonic-clonic seizure is a seizure defined by a tonic (bilateral increased tone, lasting seconds to minutes) and then a clonic (bilateral sustained rhythmic jerking) phase. Evidence: PCS. Frequency: 1/4. (PMID:22424600)
- Cerebral atrophy (HP:0002059): Atrophy (wasting, decrease in size of cells or tissue) affecting the cerebrum. Evidence: TAS. (OMIM:226750)
- Hypsarrhythmia (HP:0002521): Hypsarrhythmia is abnormal interictal high amplitude waves and a background of irregular spikes. There is continuous (during wakefulness), high-amplitude (>200 Hz), generalized polymorphic slowing with no organized background and multifocal spikes demonstrated by electroencephalography (EEG). Evidence: TAS. (OMIM:226750)
- Microcephaly (HP:0000252): Head circumference below 2 standard deviations below the mean for age and gender. Evidence: PCS. Frequency: 1/4. (PMID:22424600)
- Delayed speech and language development (HP:0000750): A degree of language development that is significantly below the norm for a child of a specified age. Evidence: PCS. Frequency: 4/4. (PMID:22424600)
- Cerebellar hypoplasia (HP:0001321): Cerebellar hypoplasia is a descriptive term implying a cerebellum with a reduced volume, but a normal shape and is stable over time. Evidence: TAS. (OMIM:226750)
- Developmental regression (HP:0002376): Loss of developmental skills, as manifested by loss of developmental milestones. Evidence: PCS. Frequency: 3/4. (PMID:22424600)
- Delayed ability to walk (HP:0031936): A failure to achieve the ability to walk at an appropriate developmental stage. Most children learn to walk in a series of stages, and learn to walk short distances independently between 12 and 15 months. Evidence: PCS. Frequency: 4/4. (PMID:22424600)
- Seizure (HP:0001250): A seizure is an intermittent abnormality of nervous system physiology characterized by a transient occurrence of signs and/or symptoms due to abnormal excessive or synchronous neuronal activity in the brain. Evidence: PCS. Frequency: 4/4. (PMID:22424600)
- Global developmental delay (HP:0001263): A delay in the achievement of motor or mental milestones in the domains of development of a child, including motor skills, speech and language, cognitive skills, and social and emotional skills. This term should only be used to describe children younger than five years of age. Evidence: TAS. Frequency: Occasional (HP:0040283). (OMIM:226750)
- Ataxia (HP:0001251): Ataxia refers to impaired coordination of voluntary muscle movement. Cerebellar ataxia refers to ataxia due to dysfunction of the cerebellum. This causes a variety of elementary neurological deficits including asynergy (lack of coordination between muscles, limbs and joints), dysmetria (lack of ability to judge distances that can lead to under- or overshoot in grasping movements), and dysdiadochokinesia (inability to perform rapid movements requiring antagonizing muscle groups to be switched on and off repeatedly). Evidence: TAS. (OMIM:226750)
- Myoclonic seizure (HP:0032794): A myoclonic seizure is a type of motor seizure characterized by sudden, brief (<100 ms) involuntary single or multiple contraction of muscles or muscle groups of variable topography (axial, proximal limb, distal). Myoclonus is less regularly repetitive and less sustained than is clonus. Evidence: PCS. Frequency: 1/4. (PMID:22424600)
- Severe intellectual disability (HP:0010864): Severe intellectual disability (ID) is defined as a type of ID characterized by severely sub-average adaptive functioning and intellectual functioning, with an intelligence quotient (IQ) the range of 20-34. Evidence: TAS. (OMIM:226750)
- Amelogenesis imperfecta (HP:0000705): A developmental dysplasia of the dental enamel. Evidence: IEA. (OMIM:226750)
- Dementia (HP:0000726): A loss of global cognitive ability of sufficient amount to interfere with normal social or occupational function. Dementia represents a loss of previously present cognitive abilities, generally in adults, and can affect memory, thinking, language, judgment, and behavior. Evidence: IEA. (OMIM:226750)
- Enamel hypoplasia (HP:0006297): Developmental hypoplasia of the dental enamel. Evidence: PCS. (PMID:22424600)
- Autosomal recessive inheritance (HP:0000007): A mode of inheritance that is observed for traits related to a gene encoded on one of the autosomes (i.e., the human chromosomes 1-22) in which a trait manifests in individuals with two pathogenic alleles, either homozygotes (two copies of the same mutant allele) or compound heterozygotes (whereby each copy of a gene has a distinct mutant allele). Evidence: PCS. (PMID:22424600)
- Epileptic encephalopathy (HP:0200134): A condition in which epileptiform abnormalities are believed to contribute to the progressive disturbance in cerebral function. Epileptic encephalaopathy is characterized by (1) electrographic EEG paroxysmal activity that is often aggressive, (2) seizures that are usually multiform and intractable, (3) cognitive, behavioral and neurological deficits that may be relentless, and (4) sometimes early death. Evidence: TAS. (OMIM:226750)
- Ventriculomegaly (HP:0002119): An increase in size of the ventricular system of the brain. Evidence: TAS. (OMIM:226750)
- Spasticity (HP:0001257): A motor disorder characterized by a velocity-dependent increase in tonic stretch reflexes with increased muscle tone, exaggerated (hyperexcitable) tendon reflexes. Evidence: IEA. (OMIM:226750)
- Focal-onset seizure (HP:0007359): A focal-onset seizure is a type of seizure originating within networks limited to one hemisphere. They may be discretely localized or more widely distributed, and may originate in subcortical structures. Evidence: PCS. Frequency: 1/4. (PMID:22424600)
- Intellectual disability (HP:0001249): The term intellectual disability or intellectual developmental disorder is used to describe significantly sub-average intellectual and adaptive functioning based on clinical assessment and as measured by individually administered, appropriately normed, standardized and validated tests of intellectual functioning and adaptive behavior, with onset during the developmental period from infancy through adolescence. Evidence: IEA. (OMIM:226750)